- Intestinal carcinoid (HP:0006723, a Human Phenotype Ontology term). Evidence: TAS. Frequency: Obligate (HP:0040280, a Human Phenotype Ontology term). (ORPHA:100079)
- Nausea and vomiting (HP:0002017, a Human Phenotype Ontology term): Nausea is a commonly encountered symptom that has been defined as an unpleasant painless subjective feeling that one will imminently vomit. Vomiting has been defined as the forceful expulsion of the contents of the stomach, duodenum, or jejunum through the oral cavity. While nausea and vomiting are often thought to exist on a temporal continuum, this is not always the case. There are situations when severe nausea may be present without emesis and less frequently, when emesis may be present without preceding nausea. Evidence: TAS. Frequency: Frequent (HP:0040282, a Human Phenotype Ontology term). (ORPHA:100079)
- Episodic abdominal pain (HP:0002574, a Human Phenotype Ontology term): An intermittent form of abdominal pain. Evidence: TAS. Frequency: Frequent (HP:0040282, a Human Phenotype Ontology term). (ORPHA:100079)
- Poor appetite (HP:0004396, a Human Phenotype Ontology term): A reduced desire to eat. Evidence: TAS. Frequency: Frequent (HP:0040282, a Human Phenotype Ontology term). (ORPHA:100079)
- Functional intestinal obstruction (HP:0005249, a Human Phenotype Ontology term). Evidence: TAS. Frequency: Frequent (HP:0040282, a Human Phenotype Ontology term). (ORPHA:100079)
- Mechanical ileus (HP:0010676, a Human Phenotype Ontology term). Evidence: TAS. Frequency: Frequent (HP:0040282, a Human Phenotype Ontology term). (ORPHA:100079)
- Abdominal colic (HP:0011848, a Human Phenotype Ontology term): A type of abdominal pain that comes and goes in waves, most often starting and ending suddenly and being of severe intensity. Evidence: TAS. Frequency: Frequent (HP:0040282, a Human Phenotype Ontology term). (ORPHA:100079)
- Bowel urgency (HP:0012701, a Human Phenotype Ontology term): A sudden, irresistible need to have a bowel movement. Evidence: TAS. Frequency: Frequent (HP:0040282, a Human Phenotype Ontology term). (ORPHA:100079)
- Abnormal bowel sounds (HP:0030142, a Human Phenotype Ontology term): An anomaly of the amount or nature of abdominal sounds. Abdominal sounds (bowel sounds) are made by the movement of the intestines as they promote passage of abdominal contents by peristalsis. Evidence: TAS. Frequency: Frequent (HP:0040282, a Human Phenotype Ontology term). (ORPHA:100079)
- Hypoactive bowel sounds (HP:0030144, a Human Phenotype Ontology term): An decreased amount of bowel sounds. Evidence: TAS. Frequency: Frequent (HP:0040282, a Human Phenotype Ontology term). (ORPHA:100079)
- Constipation (HP:0002019, a Human Phenotype Ontology term): Infrequent or difficult evacuation of feces. Evidence: TAS. Frequency: Occasional (HP:0040283, a Human Phenotype Ontology term). (ORPHA:100079)
- Anorexia (HP:0002039, a Human Phenotype Ontology term): Lack of desire to eat (loss of appetite). Evidence: TAS. Frequency: Occasional (HP:0040283, a Human Phenotype Ontology term). (ORPHA:100079)
- Hepatomegaly (HP:0002240, a Human Phenotype Ontology term): Abnormally increased size of the liver. Evidence: TAS. Frequency: Occasional (HP:0040283, a Human Phenotype Ontology term). (ORPHA:100079)
- Chronic noninfectious lymphadenopathy (HP:0002730, a Human Phenotype Ontology term): A chronic form of lymphadenopathy that is not related to infection. Evidence: TAS. Frequency: Occasional (HP:0040283, a Human Phenotype Ontology term). (ORPHA:100079)
- Elevated circulating hepatic transaminase concentration (HP:0002910, a Human Phenotype Ontology term): Elevations of the levels of SGOT and SGPT in the serum. SGOT (serum glutamic oxaloacetic transaminase) and SGPT (serum glutamic pyruvic transaminase) are transaminases primarily found in the liver and heart and are released into the bloodstream as the result of liver or heart damage. SGOT and SGPT are used clinically mainly as markers of liver damage. Evidence: TAS. Frequency: Occasional (HP:0040283, a Human Phenotype Ontology term). (ORPHA:100079)
- Elevated serum acid phosphatase (HP:0003148, a Human Phenotype Ontology term). Evidence: TAS. Frequency: Occasional (HP:0040283, a Human Phenotype Ontology term). (ORPHA:100079)
- Protracted diarrhea (HP:0004385, a Human Phenotype Ontology term). Evidence: TAS. Frequency: Occasional (HP:0040283, a Human Phenotype Ontology term). (ORPHA:100079)
- Ileal adenocarcinoma (HP:0030412, a Human Phenotype Ontology term): A malignant epithelial tumor with a glandular organization that originates in the ileum. Evidence: TAS. Frequency: Occasional (HP:0040283, a Human Phenotype Ontology term). (ORPHA:100079)
- Adenocarcinoma of the colon (HP:0040276, a Human Phenotype Ontology term). Evidence: TAS. Frequency: Occasional (HP:0040283, a Human Phenotype Ontology term). (ORPHA:100079)
- Primary hypercortisolism (HP:0001579, a Human Phenotype Ontology term): Hypercortisolemia associated with a primary defect of the adrenal gland leading to overproduction of cortisol. Evidence: TAS. Frequency: Very rare (HP:0040284, a Human Phenotype Ontology term). (ORPHA:100079)
- Palpitations (HP:0001962, a Human Phenotype Ontology term): A sensation that the heart is pounding or racing, which is a non-specific sign but may be a manifestation of arrhythmia. Evidence: TAS. Frequency: Very rare (HP:0040284, a Human Phenotype Ontology term). (ORPHA:100079)
- Asthma (HP:0002099, a Human Phenotype Ontology term): Asthma is characterized by increased responsiveness of the tracheobronchial tree to multiple stimuli, leading to narrowing of the air passages with resultant dyspnea, cough, and wheezing. Evidence: TAS. Frequency: Very rare (HP:0040284, a Human Phenotype Ontology term). (ORPHA:100079)
- Hypotension (HP:0002615, a Human Phenotype Ontology term): Low Blood Pressure, vascular hypotension. Evidence: TAS. Frequency: Very rare (HP:0040284, a Human Phenotype Ontology term). (ORPHA:100079)
- Increased serum serotonin (HP:0003144, a Human Phenotype Ontology term): A increased concentration of serotonin in the blood. Evidence: TAS. Frequency: Very rare (HP:0040284, a Human Phenotype Ontology term). (ORPHA:100079)
- Midgut malrotation (HP:0005211, a Human Phenotype Ontology term). Evidence: TAS. Frequency: Very rare (HP:0040284, a Human Phenotype Ontology term). (ORPHA:100079)
- Tricuspid stenosis (HP:0010446, a Human Phenotype Ontology term): A narrowing of the orifice of the tricuspid valve of the heart. Evidence: TAS. Frequency: Very rare (HP:0040284, a Human Phenotype Ontology term). (ORPHA:100079)
- Adrenocorticotropic hormone excess (HP:0011749, a Human Phenotype Ontology term): Overproduction of adrenocorticotropic hormone (ACTH), which generally leads secondarily to overproduction of cortisol by the adrenal cortex. Evidence: TAS. Frequency: Very rare (HP:0040284, a Human Phenotype Ontology term). (ORPHA:100079)
- Heart murmur (HP:0030148, a Human Phenotype Ontology term): An extra or unusual sound heard during a heartbeat caused vibrations resulting from the flow of blood through the heart. Evidence: TAS. Frequency: Very rare (HP:0040284, a Human Phenotype Ontology term). (ORPHA:100079)
- Appendiceal mucinous neoplasm (HP:0031499, a Human Phenotype Ontology term): An epithelial neoplasm originating in the appendix and often associated with cystic dilation of the appendix due to accumulation of gelatinous material, morphologically referred to as mucoceles. Evidence: TAS. Frequency: Very rare (HP:0040284, a Human Phenotype Ontology term). (ORPHA:100079)
- Ovarian neoplasm (HP:0100615, a Human Phenotype Ontology term): A tumor (abnormal growth of tissue) of the ovary. Evidence: TAS. Frequency: Very rare (HP:0040284, a Human Phenotype Ontology term). (ORPHA:100079)
These phenotypes are associated with the disease Neuroendocrine neoplasm of appendix (ORPHA:100079, an Orphanet rare-disease identifier).